Phenotypes associated with the disease Legg-Calve-Perthes disease (OMIM:150600):
- Avascular necrosis of the capital femoral epiphysis (HP:0005743): Avascular necrosis of the proximal epiphysis of the femur occurring in growing children and caused by an interruption of the blood supply to the head of the femur close to the hip joint. The necrosis is characteristically associated with flattening of the femoral head, for which reason the term coxa plana has been used to refer to this feature in the medical literature. Evidence: TAS. (OMIM:150600)
- Delayed skeletal maturation (HP:0002750): A decreased rate of skeletal maturation. Delayed skeletal maturation can be diagnosed on the basis of an estimation of the bone age from radiographs of specific bones in the human body. Evidence: TAS. (OMIM:150600)
- Short stature (HP:0004322): A height below that which is expected according to age and gender norms. Although there is no universally accepted definition of short stature, many refer to "short stature" as height more than 2 standard deviations below the mean for age and gender (or below the 3rd percentile for age and gender dependent norms). Evidence: TAS. (OMIM:150600)
- Non-Mendelian inheritance (HP:0001426): A mode of inheritance that depends on genetic determinants in more than one gene. Evidence: TAS. (OMIM:150600)
- Autosomal dominant inheritance (HP:0000006): A mode of inheritance that is observed for traits related to a gene encoded on one of the autosomes (i.e., the human chromosomes 1-22) in which a trait manifests in heterozygotes. In the context of medical genetics, an autosomal dominant disorder is caused when a single copy of the mutant allele is present. Males and females are affected equally, and can both transmit the disorder with a risk of 50% for each child of inheriting the mutant allele. Evidence: TAS. (OMIM:150600)